- Ataxia (HP:0001251): Ataxia refers to impaired coordination of voluntary muscle movement. Cerebellar ataxia refers to ataxia due to dysfunction of the cerebellum. This causes a variety of elementary neurological deficits including asynergy (lack of coordination between muscles, limbs and joints), dysmetria (lack of ability to judge distances that can lead to under- or overshoot in grasping movements), and dysdiadochokinesia (inability to perform rapid movements requiring antagonizing muscle groups to be switched on and off repeatedly). Evidence: IEA. (OMIM:213400)
- Autosomal recessive inheritance (HP:0000007): A mode of inheritance that is observed for traits related to a gene encoded on one of the autosomes (i.e., the human chromosomes 1-22) in which a trait manifests in individuals with two pathogenic alleles, either homozygotes (two copies of the same mutant allele) or compound heterozygotes (whereby each copy of a gene has a distinct mutant allele). Evidence: IEA. (OMIM:213400)
- Atrophy of the dentate nucleus (HP:0007047): Partial or complete wasting (loss) of dentate nucleus. Evidence: TAS. (OMIM:213400)
- Myoclonus (HP:0001336): Very brief, involuntary random muscular contractions occurring at rest, in response to sensory stimuli, or accompanying voluntary movements. Evidence: IEA. (OMIM:213400)
These phenotypes are associated with the disease myoclonic cerebellar dyssynergia (OMIM:213400).